- Constriction of peripheral visual field (HP:0001133, a Human Phenotype Ontology term): An absolute or relative decrease in retinal sensitivity extending from edge (periphery) of the visual field in a concentric pattern. The visual field is the area that is perceived simultaneously by a fixating eye. Evidence: PCS. (PMID:10581022)
- Autosomal recessive inheritance (HP:0000007, a Human Phenotype Ontology term): A mode of inheritance that is observed for traits related to a gene encoded on one of the autosomes (i.e., the human chromosomes 1-22) in which a trait manifests in individuals with two pathogenic alleles, either homozygotes (two copies of the same mutant allele) or compound heterozygotes (whereby each copy of a gene has a distinct mutant allele). Evidence: PCS. (PMID:10581022)
- Visual impairment (HP:0000505, a Human Phenotype Ontology term): Visual impairment (or vision impairment) is vision loss (of a person) to such a degree as to qualify as an additional support need through a significant limitation of visual capability resulting from either disease, trauma, or congenital or degenerative conditions that cannot be corrected by conventional means, such as refractive correction, medication, or surgery. Evidence: PCS. (PMID:10581022)
- Rod-cone dystrophy (HP:0000510, a Human Phenotype Ontology term): An inherited retinal disease subtype in which the rod photoreceptors appear to be more severely affected than the cone photoreceptors. Typical presentation is with nyctalopia (due to rod dysfunction) followed by loss of mid-peripheral field of vision, which gradually extends and leaves many patients with a small central island of vision due to the preservation of macular cones. Evidence: PCS. (PMID:10581022)
- Attenuation of retinal blood vessels (HP:0007843, a Human Phenotype Ontology term): Narrowing of the retinal blood vessels, both arterioles and venules. Evidence: PCS. (PMID:10581022)
- Autosomal dominant inheritance (HP:0000006, a Human Phenotype Ontology term): A mode of inheritance that is observed for traits related to a gene encoded on one of the autosomes (i.e., the human chromosomes 1-22) in which a trait manifests in heterozygotes. In the context of medical genetics, an autosomal dominant disorder is caused when a single copy of the mutant allele is present. Males and females are affected equally, and can both transmit the disorder with a risk of 50% for each child of inheriting the mutant allele. Evidence: PCS. (PMID:10581022)
- Decreased light- and dark-adapted electroretinogram amplitude (HP:0000654, a Human Phenotype Ontology term): Decreased amplitude of eletrical response upon electroretinography. Evidence: PCS. (PMID:10581022)
These phenotypes are associated with the disease retinitis pigmentosa 44 (OMIM:613769, an entry in Online Mendelian Inheritance in Man).